- Expressive language delay (HP:0002474): A delay in the acquisition of the ability to use language to communicate needs, wishes, or thoughts. Evidence: IEA. (OMIM:606712)
- Language impairment (HP:0002463): Language impairment is a deficit in comprehension or production of language that includes reduced vocabulary, limited sentence structure, or impairments in written or spoken communication. Language abilities are substantially and quantifiably below age expectations. Evidence: IEA. (OMIM:606712)
- Non-Mendelian inheritance (HP:0001426): A mode of inheritance that depends on genetic determinants in more than one gene. Evidence: IEA. (OMIM:606712)
- Deficit in nonword repetition (HP:0002526): Impaired ability to repeat non-word sounds. Nonword repetition (NWR) is a measure of short-term phonological memory. Evidence: IEA. (OMIM:606712)
- Deficit in phonologic short-term memory (HP:0002549): Impaired ability to repeat non-word sounds. The test for nonword repetition involves the repetition of nonsensical words of increasing length and complexity and is regarded as a measure of phonological (speech sound) processing and short-term memory. Evidence: IEA. (OMIM:606712)
These phenotypes are associated with the disease specific language impairment 2 (OMIM:606712).